- Absence of acoustic reflex (HP:0008529): Absence of the acoustic reflex, an involuntary contraction of the stapedius muscle that occurs in response to high-intensity sound stimuli. Evidence: TAS. (OMIM:601071)
- Congenital onset (HP:0003577): A phenotypic abnormality that is present at birth. Evidence: PCS. (PMID:10192385)
- Sensorineural hearing impairment (HP:0000407): A type of hearing impairment in one or both ears related to an abnormal functionality of the cochlear nerve. Evidence: PCS. (PMID:10192385)
- Sensorineural hearing impairment (HP:0000407): A type of hearing impairment in one or both ears related to an abnormal functionality of the cochlear nerve. Evidence: PCS. Frequency: 3/3. Onset: Congenital onset (HP:0003577). (PMID:10192385)
- Absent brainstem auditory responses (HP:0004463): Lack of measurable response to stimulation of auditory evoked potentials. Evidence: TAS. (OMIM:601071)
- Autosomal recessive inheritance (HP:0000007): A mode of inheritance that is observed for traits related to a gene encoded on one of the autosomes (i.e., the human chromosomes 1-22) in which a trait manifests in individuals with two pathogenic alleles, either homozygotes (two copies of the same mutant allele) or compound heterozygotes (whereby each copy of a gene has a distinct mutant allele). Evidence: PCS. (PMID:10192385)
These phenotypes are associated with the disease autosomal recessive nonsyndromic hearing loss 9 (OMIM:601071).